- Colon cancer (HP:0003003). Evidence: PCS. (PMID:18372901;PMID:17934461;PMID:18372905)
This phenotype is associated with the disease colorectal cancer, susceptibility to, 3 (OMIM:612229).